- Juvenile onset (HP:0003621): Onset of signs or symptoms of disease between the age of 5 and 15 years. Evidence: PCS. Frequency: 2/2. (PMID:25691535)
- Focal aware cognitive seizure with forced thinking (HP:0032705): A focal cognitive seizure with forced thinking characterized by retained awareness throughout the seizure. Evidence: PCS. Frequency: 1/2. (PMID:25691535)
- Focal impaired awareness seizure (HP:0002384): Focal impaired awareness seizure (or focal seizure with impaired or lost awareness) is a type of focal-onset seizure characterized by some degree (which may be partial) of impairment of the person's awareness of themselves or their surroundings at any point during the seizure. Evidence: TAS. (OMIM:616461)
- Focal impaired awareness seizure (HP:0002384): Focal impaired awareness seizure (or focal seizure with impaired or lost awareness) is a type of focal-onset seizure characterized by some degree (which may be partial) of impairment of the person's awareness of themselves or their surroundings at any point during the seizure. Evidence: PCS. Frequency: 2/2. Onset: Young adult onset (HP:0011462). (PMID:25691535)
- Bilateral tonic-clonic seizure with focal onset (HP:0007334): A bilateral tonic-clonic seizure with focal onset is a focal-onset seizure which progresses into a bilateral tonic-clonic phase. Evidence: PCS. Frequency: 2/2. (PMID:25691535)
- Focal aware autonomic seizure with epigastric sensation/nausea/vomiting/other gastrointestinal phenomena (HP:0032785): A focal autonomic seizure with epigastric sensation / nausea / vomiting / other gastrointestinal phenomena characterized by retained awareness throughout the seizure. Evidence: PCS. Frequency: 1/2. (PMID:25691535)
- Focal aware sensory seizure with auditory features (HP:0032864): A type of focal sensory seizure with auditory features during which awareness is retained throughout the seizure. Evidence: PCS. Frequency: 1/2. (PMID:25691535)
- Deja vu aura (HP:0012005): A subjective feeling that an experience which is occurring for the first time has been experienced before. Evidence: PCS. Frequency: 2/2. (PMID:25691535)
- Autosomal dominant inheritance (HP:0000006): A mode of inheritance that is observed for traits related to a gene encoded on one of the autosomes (i.e., the human chromosomes 1-22) in which a trait manifests in heterozygotes. In the context of medical genetics, an autosomal dominant disorder is caused when a single copy of the mutant allele is present. Males and females are affected equally, and can both transmit the disorder with a risk of 50% for each child of inheriting the mutant allele. Evidence: PCS. (PMID:25691535)
These phenotypes are associated with the disease familial temporal lobe epilepsy 8 (OMIM:616461).